Phenotypes associated with the disease spinocerebellar ataxia, X-linked 2 (OMIM:302600):
- Ataxia (HP:0001251): Ataxia refers to impaired coordination of voluntary muscle movement. Cerebellar ataxia refers to ataxia due to dysfunction of the cerebellum. This causes a variety of elementary neurological deficits including asynergy (lack of coordination between muscles, limbs and joints), dysmetria (lack of ability to judge distances that can lead to under- or overshoot in grasping movements), and dysdiadochokinesia (inability to perform rapid movements requiring antagonizing muscle groups to be switched on and off repeatedly). Evidence: IEA. (OMIM:302600)
- X-linked inheritance (HP:0001417): A mode of inheritance that is observed for traits related to a gene encoded on the X chromosome. Evidence: IEA. (OMIM:302600)
- Abnormality of extrapyramidal motor function (HP:0002071): A neurological condition related to lesions of the basal ganglia leading to typical abnormalities including akinesia (inability to initiate changes in activity and perform volitional movements rapidly and easily), muscular rigidity (continuous contraction of muscles with constant resistance to passive movement), chorea (widespread arrhythmic movements of a forcible, rapid, jerky, and restless nature), athetosis (inability to sustain the muscles of the fingers, toes, or other group of muscles in a fixed position), and akathisia (inability to remain motionless). Evidence: IEA. (OMIM:302600)